Phenotypes associated with the disease patent ductus arteriosus 2 (OMIM:617035):
- Congenital onset (HP:0003577): A phenotypic abnormality that is present at birth. Evidence: PCS. Frequency: 6/6. (PMID:18752453)
- Clinodactyly of the 5th finger (HP:0004209): Clinodactyly refers to a bending or curvature of the fifth finger in the radial direction (i.e., towards the 4th finger). Evidence: PCS. Frequency: 0/6. (PMID:18752453)
- Patent ductus arteriosus (HP:0001643): In utero, the ductus arteriosus (DA) serves to divert ventricular output away from the lungs and toward the placenta by connecting the main pulmonary artery to the descending aorta. A patent ductus arteriosus (PDA) in the first 3 days of life is a physiologic shunt in healthy term and preterm newborn infants, and normally is substantially closed within about 24 hours after bith and completely closed after about three weeks. Failure of physiologcal closure is referred to a persistent or patent ductus arteriosus (PDA). Depending on the degree of left-to-right shunting, PDA can have clinical consequences. Evidence: PCS. Frequency: 6/6. (PMID:18752453)
- Autosomal dominant inheritance (HP:0000006): A mode of inheritance that is observed for traits related to a gene encoded on one of the autosomes (i.e., the human chromosomes 1-22) in which a trait manifests in heterozygotes. In the context of medical genetics, an autosomal dominant disorder is caused when a single copy of the mutant allele is present. Males and females are affected equally, and can both transmit the disorder with a risk of 50% for each child of inheriting the mutant allele. Evidence: PCS. (PMID:18752453)